- Abnormality of the dentition (HP:0000164): Any abnormality of the teeth. Evidence: TAS. Frequency: Very frequent (HP:0040281). (ORPHA:1811)
- Carious teeth (HP:0000670): Caries is a multifactorial bacterial infection affecting the structure of the tooth. This term has been used to describe the presence of more than expected dental caries. Evidence: TAS. Frequency: Very frequent (HP:0040281). (ORPHA:1811)
- Ectodermal dysplasia (HP:0000968): Ectodermal dysplasia is a group of conditions in which there is abnormal development of the skin, hair, nails, teeth, or sweat glands. Evidence: TAS. Frequency: Very frequent (HP:0040281). (ORPHA:1811)
- Abnormal nail morphology (HP:0001597): Abnormal structure or appearance of the nail. Evidence: TAS. Frequency: Very frequent (HP:0040281). (ORPHA:1811)
- Short nail (HP:0001799): Decreased length of nail. Evidence: TAS. Frequency: Very frequent (HP:0040281). (ORPHA:1811)
- Thin nail (HP:0001816): Nail that appears thin when viewed on end. Evidence: TAS. Frequency: Very frequent (HP:0040281). (ORPHA:1811)
- Premature loss of primary teeth (HP:0006323): Loss of the primary (also known as deciduous) teeth before the usual age. Evidence: TAS. Frequency: Very frequent (HP:0040281). (ORPHA:1811)
- Premature eruption of permanent teeth (HP:0006337): Premature tooth eruption of the permanent dentition. Evidence: TAS. Frequency: Very frequent (HP:0040281). (ORPHA:1811)
- Slow-growing nails (HP:0008383): Nails whose growth is slower than normal. Evidence: TAS. Frequency: Very frequent (HP:0040281). (ORPHA:1811)
These phenotypes are associated with the disease Odontomicronychial dysplasia (ORPHA:1811).